Phenotypes associated with the disease Watson syndrome (OMIM:193520):
- Neurofibroma (HP:0001067): A benign peripheral nerve sheath tumor that generally appears as a soft, skin-colored papule or small subcutaneous nodule. Individuals with neurofibromatosis can have numerous neurofibromas. Evidence: IEA. (OMIM:193520)
- Epicanthus (HP:0000286): A fold of skin starting above the medial aspect of the upper eyelid and arching downward to cover, pass in front of and lateral to the medial canthus. Evidence: PCS. Frequency: 2/3. (PMID:8317503)
- Congenital onset (HP:0003577): A phenotypic abnormality that is present at birth. Evidence: PCS. Frequency: 3/3. (PMID:8317503)
- Short stature (HP:0004322): A height below that which is expected according to age and gender norms. Although there is no universally accepted definition of short stature, many refer to "short stature" as height more than 2 standard deviations below the mean for age and gender (or below the 3rd percentile for age and gender dependent norms). Evidence: IEA. (OMIM:193520)
- Relative macrocephaly (HP:0004482): A relatively mild degree of macrocephaly in which the head circumference is not above two standard deviations from the mean, but appears dysproportionately large when other factors such as body stature are taken into account. Evidence: IEA. (OMIM:193520)
- Moderate global developmental delay (HP:0011343): A moderate delay in the achievement of motor or mental milestones in the domains of development of a child. Evidence: PCS. Frequency: 2/3. (PMID:8317503)
- Hypertelorism (HP:0000316): Interpupillary distance more than 2 SD above the mean (alternatively, the appearance of an increased interpupillary distance or widely spaced eyes). Evidence: PCS. Frequency: 2/3. (PMID:8317503)
- Axillary freckling (HP:0000997): The presence in the axillary region (armpit) of an increased number of freckles, small circular spots on the skin that are darker than the surrounding skin because of deposits of melanin. Evidence: PCS. Frequency: 1/3. (PMID:8317503)
- Multiple cafe-au-lait spots (HP:0007565): The presence of six or more cafe-au-lait spots. Evidence: PCS. Frequency: 3/3. (PMID:8317503)
- Inguinal freckling (HP:0030052): The presence in the inguinal region (groin) of an increased number of freckles, small circular spots on the skin that are darker than the surrounding skin because of deposits of melanin. Evidence: PCS. Frequency: 1/3. (PMID:8317503)
- Pectus carinatum (HP:0000768): A deformity of the chest caused by overgrowth of the ribs and characterized by protrusion of the sternum. Evidence: PCS. Frequency: 2/3. (PMID:8317503)
- Pulmonic stenosis (HP:0001642): A narrowing of the right ventricular outflow tract that can occur at the pulmonary valve (valvular stenosis), below the pulmonary valve (infundibular stenosis), or above the pulmonary valve (supravalvar stenosis). Evidence: PCS. Frequency: 1/3. (PMID:8317503)
- Autosomal dominant inheritance (HP:0000006): A mode of inheritance that is observed for traits related to a gene encoded on one of the autosomes (i.e., the human chromosomes 1-22) in which a trait manifests in heterozygotes. In the context of medical genetics, an autosomal dominant disorder is caused when a single copy of the mutant allele is present. Males and females are affected equally, and can both transmit the disorder with a risk of 50% for each child of inheriting the mutant allele. Evidence: PCS. (PMID:8317503)
- Lisch nodules (HP:0009737): The presence of pigmented, oval and dome-shaped raised hamartomatous nevi of the iris.. Evidence: PCS. Frequency: 0/3. (PMID:8317503)
- Posteriorly rotated ears (HP:0000358): A type of abnormal location of the ears in which the position of the ears is characterized by posterior rotation (the superior part of the ears is rotated towards the back of the head, and the inferior part of the ears towards the front). Evidence: PCS. Frequency: 3/3. (PMID:8317503)
- Low-set ears (HP:0000369): Upper insertion of the ear to the scalp below an imaginary horizontal line drawn between the inner canthi of the eye and extending posteriorly to the ear. Evidence: PCS. Frequency: 3/3. (PMID:8317503)